Phenotypes associated with the disease CAR T cell therapy-associated cytokine release syndrome (ORPHA:542323):
- Fever (HP:0001945): Body temperature elevated above the normal range. Evidence: TAS. Frequency: Very frequent (HP:0040281). (ORPHA:542323)
- Abnormal circulating cytokine concentration (HP:0011112): Abnormality of the cytokine levels in the blood, i.e., an abnormality of any of the non-antibody proteins made by inflammatory leukocytes and some non-leukocytic cells that affect the behavior of other cells. Evidence: TAS. Frequency: Very frequent (HP:0040281). (ORPHA:542323)
- Abnormal circulating interleukin concentration (HP:0011117): The concentration of an interleukin (a class of cytokines) is outside the limits of normal. Evidence: TAS. Frequency: Very frequent (HP:0040281). (ORPHA:542323)
- Fatigue (HP:0012378): A subjective feeling of tiredness characterized by a lack of energy and motivation. Evidence: TAS. Frequency: Very frequent (HP:0040281). (ORPHA:542323)
- Increased inflammatory response (HP:0012649): A abnormal increase in the inflammatory response to injury or infection. Evidence: TAS. Frequency: Very frequent (HP:0040281). (ORPHA:542323)
- Tachycardia (HP:0001649): A rapid heartrate that exceeds the range of the normal resting heartrate for age. Evidence: TAS. Frequency: Frequent (HP:0040282). (ORPHA:542323)
- Hypotension (HP:0002615): Low Blood Pressure, vascular hypotension. Evidence: TAS. Frequency: Frequent (HP:0040282). (ORPHA:542323)
- Myalgia (HP:0003326): Pain in muscle. Evidence: TAS. Frequency: Frequent (HP:0040282). (ORPHA:542323)
- Poor appetite (HP:0004396): A reduced desire to eat. Evidence: TAS. Frequency: Frequent (HP:0040282). (ORPHA:542323)
- Increased circulating interferon-gamma concentration (HP:0030356): An elevation in the concentration of interferon gamma measured in the blood circulation. Evidence: TAS. Frequency: Frequent (HP:0040282). (ORPHA:542323)
- Increased circulating interleukin 6 concentration (HP:0030783): The concentration of interleukin-6 in the blood circulation is above the upper limit of normal. Evidence: TAS. Frequency: Frequent (HP:0040282). (ORPHA:542323)
- Confusion (HP:0001289): Lack of clarity and coherence of thought, perception, understanding, or action. Evidence: TAS. Frequency: Occasional (HP:0040283). (ORPHA:542323)
- Vomiting (HP:0002013): Forceful ejection of the contents of the stomach through the mouth by means of a series of involuntary spasmic contractions. Evidence: TAS. Frequency: Occasional (HP:0040283). (ORPHA:542323)
- Diarrhea (HP:0002014): Abnormally increased frequency (usually defined as three or more) loose or watery bowel movements a day. Evidence: TAS. Frequency: Occasional (HP:0040283). (ORPHA:542323)
- Nausea (HP:0002018): A sensation of unease in the stomach together with an urge to vomit. Evidence: TAS. Frequency: Occasional (HP:0040283). (ORPHA:542323)
- Pleural effusion (HP:0002202): The presence of an excessive amount of fluid in the pleural cavity. Evidence: TAS. Frequency: Occasional (HP:0040283). (ORPHA:542323)
- Tachypnea (HP:0002789): Very rapid breathing. Evidence: TAS. Frequency: Occasional (HP:0040283). (ORPHA:542323)
- Hyperbilirubinemia (HP:0002904): An increased amount of bilirubin in the blood. Evidence: TAS. Frequency: Occasional (HP:0040283). (ORPHA:542323)
- Elevated circulating hepatic transaminase concentration (HP:0002910): Elevations of the levels of SGOT and SGPT in the serum. SGOT (serum glutamic oxaloacetic transaminase) and SGPT (serum glutamic pyruvic transaminase) are transaminases primarily found in the liver and heart and are released into the bloodstream as the result of liver or heart damage. SGOT and SGPT are used clinically mainly as markers of liver damage. Evidence: TAS. Frequency: Occasional (HP:0040283). (ORPHA:542323)
- Elevated circulating creatinine concentration (HP:0003259): An increased amount of creatinine in the blood. Evidence: TAS. Frequency: Occasional (HP:0040283). (ORPHA:542323)
- Decreased urine output (HP:0011037): A decreased rate of urine production. Evidence: TAS. Frequency: Occasional (HP:0040283). (ORPHA:542323)
- Arrhythmia (HP:0011675): Any cardiac rhythm other than the normal sinus rhythm. Such a rhythm may be either of sinus or ectopic origin and either regular or irregular. An arrhythmia may be due to a disturbance in impulse formation or conduction or both. Evidence: TAS. Frequency: Occasional (HP:0040283). (ORPHA:542323)
- Hypoxemia (HP:0012418): An abnormally low level of blood oxygen. Evidence: TAS. Frequency: Occasional (HP:0040283). (ORPHA:542323)
- Reduced left ventricular ejection fraction (HP:0012664): A diminution of the volumetric fraction of blood pumped out of the ventricle with each cardiac cycle. Evidence: TAS. Frequency: Occasional (HP:0040283). (ORPHA:542323)
- Heart block (HP:0012722): Impaired conduction of cardiac impulse occurring anywhere along the conduction pathway. Evidence: TAS. Frequency: Occasional (HP:0040283). (ORPHA:542323)
- Capillary leak (HP:0030005): An acute phenomenon characterized by hypotension and anasarca due to the loss of plasma volume into peripheral tissues, with evidence of decreased plasma volume (hemoconcentration) and protein loss from the intravascular space (hypoalbuminemia) during acute episodes. Evidence: TAS. Frequency: Occasional (HP:0040283). (ORPHA:542323)
- Pulmonary edema (HP:0100598): Fluid accumulation in the lungs. Evidence: TAS. Frequency: Occasional (HP:0040283). (ORPHA:542323)
- Skin rash (HP:0000988): A red eruption of the skin. Evidence: TAS. Frequency: Very rare (HP:0040284). (ORPHA:542323)
- Acute kidney injury (HP:0001919): Sudden loss of renal function, as manifested by decreased urine production, and a rise in serum creatinine or blood urea nitrogen concentration (azotemia). Evidence: TAS. Frequency: Very rare (HP:0040284). (ORPHA:542323)
- Respiratory failure (HP:0002878): A severe form of respiratory insufficiency characterized by inadequate gas exchange such that the levels of oxygen or carbon dioxide cannot be maintained within normal limits. Evidence: TAS. Frequency: Very rare (HP:0040284). (ORPHA:542323)
- Disseminated intravascular coagulation (HP:0005521): Disseminated intravascular coagulation is characterized by the widespread activation of coagulation, which results in the intravascular formation of fibrin and ultimately thrombotic occlusion of small and midsize vessels. Evidence: TAS. Frequency: Very rare (HP:0040284). (ORPHA:542323)